- Cleft palate (HP:0000175): Cleft palate is a developmental defect of the palate resulting from a failure of fusion of the palatine processes and manifesting as a separation of the roof of the mouth (soft and hard palate). Evidence: TAS. Frequency: Very frequent (HP:0040281). (ORPHA:1226)
- Retrognathia (HP:0000278): An abnormality in which the mandible is mislocalised posteriorly. Evidence: TAS. Frequency: Very frequent (HP:0040281). (ORPHA:1226)
- Choanal atresia (HP:0000453): Absence or abnormal closure of the choana (the posterior nasal aperture). Most embryologists believe that posterior choanal atresia results from a failure of rupture between the 35th and 38th day of fetal life of the partition which separates the bucconasal or buccopharyngeal membranes. The resultant choanal atresia may be unilateral or bilateral, bony or membranous, complete or incomplete. In over 90 per cent of cases the obstruction is bony, while in the remainder it is membranous. The bony type of atresia is commonly located 1-2 mm. anterior to the posterior edge of the hard palate, and the osseous septum varies in thickness from 1 to 10 mm. In the membranous form of choanal atresia the obstruction usually occurs further posteriorly. In approximately one third of cases the atresia is bilateral. Evidence: TAS. Frequency: Very frequent (HP:0040281). (ORPHA:1226)
- Congenital hypothyroidism (HP:0000851): A type of hypothyroidism with congenital onset. Evidence: TAS. Frequency: Very frequent (HP:0040281). (ORPHA:1226)
- Intellectual disability (HP:0001249): The term intellectual disability or intellectual developmental disorder is used to describe significantly sub-average intellectual and adaptive functioning based on clinical assessment and as measured by individually administered, appropriately normed, standardized and validated tests of intellectual functioning and adaptive behavior, with onset during the developmental period from infancy through adolescence. Evidence: TAS. Frequency: Very frequent (HP:0040281). (ORPHA:1226)
- Polyhydramnios (HP:0001561): The presence of excess amniotic fluid in the uterus during pregnancy. Evidence: TAS. Frequency: Very frequent (HP:0040281). (ORPHA:1226)
- Thyroid agenesis (HP:0008191): The congenital absence of the thyroid gland. Evidence: TAS. Frequency: Very frequent (HP:0040281). (ORPHA:1226)
- Abnormal hair quantity (HP:0011362): An abnormal amount of hair. Evidence: TAS. Frequency: Very frequent (HP:0040281). (ORPHA:1226)
These phenotypes are associated with the disease Bamforth-Lazarus syndrome (ORPHA:1226).